- Poor wound healing (HP:0001058): A reduced ability to heal cutaneous wounds. Evidence: TAS. Frequency: Very frequent (HP:0040281). (ORPHA:99921)
- Thickened skin (HP:0001072): Laminar thickening of skin. Evidence: TAS. Frequency: Very frequent (HP:0040281). (ORPHA:99921)
- Intermittent generalized erythematous papular rash (HP:0007432). Evidence: TAS. Frequency: Very frequent (HP:0040281). (ORPHA:99921)
- Xerostomia (HP:0000217): Dryness of the mouth due to salivary gland dysfunction. Evidence: TAS. Frequency: Frequent (HP:0040282). (ORPHA:99921)
- Recurrent corneal erosions (HP:0000495): The presence of recurrent corneal epithelial erosions. Although most corneal epithelial defects heal quickly, some may show recurrent ulcerations. Evidence: TAS. Frequency: Frequent (HP:0040282). (ORPHA:99921)
- Photophobia (HP:0000613): Excessive sensitivity to light with the sensation of discomfort or pain in the eyes due to exposure to bright light. Evidence: TAS. Frequency: Frequent (HP:0040282). (ORPHA:99921)
- Abnormal skin pigmentation (HP:0001000): An abnormality of the pigmentation of the skin. Evidence: TAS. Frequency: Frequent (HP:0040282). (ORPHA:99921)
- Keratoconjunctivitis sicca (HP:0001097): Dryness of the eye related to deficiency of the tear film components (aqueous, mucin, or lipid), lid surface abnormalities, or epithelial abnormalities. Keratoconjunctivitis sicca often results in a scratchy or sandy sensation (foreign body sensation) in the eyes, and may also be associated with itching, inability to produce tears, photosensitivity, redness, pain, and difficulty in moving the eyelids. Evidence: TAS. Frequency: Frequent (HP:0040282). (ORPHA:99921)
- Alopecia (HP:0001596): A noncongenital process of hair loss, which may progress to partial or complete baldness. Evidence: TAS. Frequency: Frequent (HP:0040282). (ORPHA:99921)
- Onycholysis (HP:0001806): Detachment of the nail from the nail bed. Evidence: TAS. Frequency: Frequent (HP:0040282). (ORPHA:99921)
- Bronchiectasis (HP:0002110): Persistent abnormal dilatation of the bronchi owing to localized and irreversible destruction and widening of the large airways. Evidence: TAS. Frequency: Frequent (HP:0040282). (ORPHA:99921)
- Recurrent infections (HP:0002719): Increased susceptibility to infections as manifested by repeated bouts of infection. Evidence: TAS. Frequency: Frequent (HP:0040282). (ORPHA:99921)
- Elevated circulating hepatic transaminase concentration (HP:0002910): Elevations of the levels of SGOT and SGPT in the serum. SGOT (serum glutamic oxaloacetic transaminase) and SGPT (serum glutamic pyruvic transaminase) are transaminases primarily found in the liver and heart and are released into the bloodstream as the result of liver or heart damage. SGOT and SGPT are used clinically mainly as markers of liver damage. Evidence: TAS. Frequency: Frequent (HP:0040282). (ORPHA:99921)
- Nail dystrophy (HP:0008404): Onychodystrophy (nail dystrophy) refers to nail changes apart from changes of the color (nail dyschromia) and involves partial or complete disruption of the various keratinous layers of the nail plate. Evidence: TAS. Frequency: Frequent (HP:0040282). (ORPHA:99921)
- Erythema (HP:0010783): Redness of the skin, caused by hyperemia of the capillaries in the lower layers of the skin. Evidence: TAS. Frequency: Frequent (HP:0040282). (ORPHA:99921)
- Food intolerance (HP:0012537): A detrimental reaction to a food, beverage, food additive, or compound found in foods that produces symptoms in one or more body organs and systems that is not mediated by an immune reaction. Evidence: TAS. Frequency: Frequent (HP:0040282). (ORPHA:99921)
- Abnormal vagina morphology (HP:0000142): Any structural abnormality of the vagina. Evidence: TAS. Frequency: Occasional (HP:0040283). (ORPHA:99921)
- Hematuria (HP:0000790): The presence of blood in the urine. Hematuria may be gross hematuria (visible to the naked eye) or microscopic hematuria (detected by dipstick or microscopic examination of the urine). Evidence: TAS. Frequency: Occasional (HP:0040283). (ORPHA:99921)
- Muscle weakness (HP:0001324): Reduced strength of muscles. Evidence: TAS. Frequency: Occasional (HP:0040283). (ORPHA:99921)
- Arthritis (HP:0001369): Inflammation of a joint. Evidence: TAS. Frequency: Occasional (HP:0040283). (ORPHA:99921)
- Flexion contracture (HP:0001371): A flexion contracture is a bent (flexed) joint that cannot be straightened actively or passively. It is thus a chronic loss of joint motion due to structural changes in muscle, tendons, ligaments, or skin that prevents normal movement of joints. Evidence: TAS. Frequency: Occasional (HP:0040283). (ORPHA:99921)
- Ascites (HP:0001541): Accumulation of fluid in the peritoneal cavity (between the layers of the peritoneum that lines the abdomen). Evidence: TAS. Frequency: Occasional (HP:0040283). (ORPHA:99921)
- Phimosis (HP:0001741): The male foreskin cannot be fully retracted from the head of the penis. Evidence: TAS. Frequency: Occasional (HP:0040283). (ORPHA:99921)
- Weight loss (HP:0001824): Reduction of total body weight. Evidence: TAS. Frequency: Occasional (HP:0040283). (ORPHA:99921)
- Pancytopenia (HP:0001876): An abnormal reduction in numbers of all blood cell types (red blood cells, white blood cells, and platelets). Evidence: TAS. Frequency: Occasional (HP:0040283). (ORPHA:99921)
- Diarrhea (HP:0002014): Abnormally increased frequency (usually defined as three or more) loose or watery bowel movements a day. Evidence: TAS. Frequency: Occasional (HP:0040283). (ORPHA:99921)
- Dysphagia (HP:0002015): Difficulty in swallowing. Evidence: TAS. Frequency: Occasional (HP:0040283). (ORPHA:99921)
- Nausea (HP:0002018): A sensation of unease in the stomach together with an urge to vomit. Evidence: TAS. Frequency: Occasional (HP:0040283). (ORPHA:99921)
- Gastroesophageal reflux (HP:0002020): A condition in which the stomach contents leak backwards from the stomach into the esophagus through the lower esophageal sphincter. Evidence: TAS. Frequency: Occasional (HP:0040283). (ORPHA:99921)
- Abdominal pain (HP:0002027): An unpleasant sensation characterized by physical discomfort (such as pricking, throbbing, or aching) and perceived to originate in the abdomen. Evidence: TAS. Frequency: Occasional (HP:0040283). (ORPHA:99921)
- Abnormal esophagus morphology (HP:0002031): A structural abnormality of the esophagus. Evidence: TAS. Frequency: Occasional (HP:0040283). (ORPHA:99921)
- Anorexia (HP:0002039): Lack of desire to eat (loss of appetite). Evidence: TAS. Frequency: Occasional (HP:0040283). (ORPHA:99921)
- Esophageal stricture (HP:0002043): A pathological narrowing of the esophagus that is caused by the development of a ring of scar tissue that constricts the esophageal lumen. Evidence: TAS. Frequency: Occasional (HP:0040283). (ORPHA:99921)
- Dyspnea (HP:0002094): Difficult or labored breathing. Dyspnea is a subjective feeling only the patient can rate, e.g., on a Borg scale. Evidence: TAS. Frequency: Occasional (HP:0040283). (ORPHA:99921)
- Pneumothorax (HP:0002107): Accumulation of air in the pleural cavity leading to a partially or completely collapsed lung. Evidence: TAS. Frequency: Occasional (HP:0040283). (ORPHA:99921)
- Pulmonary infiltrates (HP:0002113). Evidence: TAS. Frequency: Occasional (HP:0040283). (ORPHA:99921)
- Pleural effusion (HP:0002202): The presence of an excessive amount of fluid in the pleural cavity. Evidence: TAS. Frequency: Occasional (HP:0040283). (ORPHA:99921)
- Arthralgia (HP:0002829): Joint pain. Evidence: TAS. Frequency: Occasional (HP:0040283). (ORPHA:99921)
- Myalgia (HP:0003326): Pain in muscle. Evidence: TAS. Frequency: Occasional (HP:0040283). (ORPHA:99921)
- Esophageal ulceration (HP:0004791): Defect in the epithelium of the esophagus, essentially an open sore in the lining of the esophagus. Evidence: TAS. Frequency: Occasional (HP:0040283). (ORPHA:99921)
- Airway obstruction (HP:0006536): Obstruction of conducting airways of the lung. Evidence: TAS. Frequency: Occasional (HP:0040283). (ORPHA:99921)
- Bronchiolitis obliterans (HP:0011946): Inflammation and fibrosis of the bronchioles leading to partial or complete obstruction of these airways. Evidence: TAS. Frequency: Occasional (HP:0040283). (ORPHA:99921)
- Entrapment neuropathy (HP:0012181): Malfunction of a peripheral nerve resulting from mechanical compression of the nerve roots from internal or external causes and leading to a conduction block or axonal loss. Evidence: TAS. Frequency: Occasional (HP:0040283). (ORPHA:99921)
- Morphea (HP:0012344): Isolated patches of hardened skin (scleroderma). Evidence: TAS. Frequency: Occasional (HP:0040283). (ORPHA:99921)
- Pain (HP:0012531): An unpleasant sensory and emotional experience associated with actual or potential tissue damage, or described in terms of such damage. Evidence: TAS. Frequency: Occasional (HP:0040283). (ORPHA:99921)
- Cough (HP:0012735): A sudden, audible expulsion of air from the lungs through a partially closed glottis, preceded by inhalation. Evidence: TAS. Frequency: Occasional (HP:0040283). (ORPHA:99921)
- Abnormal esophagus physiology (HP:0025270): Any physiological abnormality of the esophagus. Evidence: TAS. Frequency: Occasional (HP:0040283). (ORPHA:99921)
- Wheezing (HP:0030828): A high-pitched whistling sound associated with labored breathing. Evidence: TAS. Frequency: Occasional (HP:0040283). (ORPHA:99921)
- Fasciitis (HP:0100537): Inflammation of fascia, the tissue under the skin and over the muscle. Evidence: TAS. Frequency: Occasional (HP:0040283). (ORPHA:99921)
- Urinary bladder inflammation (HP:0100577): Inflammation of the urinary bladder. Evidence: TAS. Frequency: Occasional (HP:0040283). (ORPHA:99921)
- Chest pain (HP:0100749): An unpleasant sensation characterized by physical discomfort (such as pricking, throbbing, or aching) localized to the chest. Evidence: TAS. Frequency: Occasional (HP:0040283). (ORPHA:99921)
- Skin vesicle (HP:0200037): A circumscribed, fluid-containing, epidermal elevation less than 10mm in diameter at the widest point that (i) Contain serous exudates or serum mixed with blood or pus; (ii) Are discrete, grouped, irregularly distributed, or linear as in Rhus dermatitis; (iii) Are short-lived. Vesicles may break spontaneously or evolve into bullae by enlarging or coalescing with other vesicles. Evidence: TAS. Frequency: Occasional (HP:0040283). (ORPHA:99921)
- Skin ulcer (HP:0200042): A discontinuity of the skin exhibiting complete loss of the epidermis and often portions of the dermis and even subcutaneous fat. Evidence: TAS. Frequency: Occasional (HP:0040283). (ORPHA:99921)
These phenotypes are associated with the disease Chronic graft versus host disease (ORPHA:99921).